Phenotypes associated with the disease Unilateral polymicrogyria (ORPHA:268943):
- Intellectual disability (HP:0001249): The term intellectual disability or intellectual developmental disorder is used to describe significantly sub-average intellectual and adaptive functioning based on clinical assessment and as measured by individually administered, appropriately normed, standardized and validated tests of intellectual functioning and adaptive behavior, with onset during the developmental period from infancy through adolescence. Evidence: TAS. Frequency: Frequent (HP:0040282). (ORPHA:268943)
- Seizure (HP:0001250): A seizure is an intermittent abnormality of nervous system physiology characterized by a transient occurrence of signs and/or symptoms due to abnormal excessive or synchronous neuronal activity in the brain. Evidence: TAS. Frequency: Frequent (HP:0040282). (ORPHA:268943)
- Hemiparesis (HP:0001269): Loss of strength in the arm, leg, and sometimes face on one side of the body. Hemiplegia refers to a complete loss of strength, whereas hemiparesis refers to an incomplete loss of strength. Evidence: TAS. Frequency: Frequent (HP:0040282). (ORPHA:268943)
- Spastic tetraplegia (HP:0002510): Spastic paralysis affecting all four limbs. Evidence: TAS. Frequency: Frequent (HP:0040282). (ORPHA:268943)
- Cortical dysplasia (HP:0002539): The presence of developmental dysplasia of the cerebral cortex. Evidence: TAS. Frequency: Frequent (HP:0040282). (ORPHA:268943)
- Poor fine motor coordination (HP:0007010): An abnormality of the ability (skills) to perform a precise movement of small muscles with the intent to perform a specific act. Fine motor skills are required to mediate movements of the wrists, hands, fingers, feet, and toes. Evidence: TAS. Frequency: Frequent (HP:0040282). (ORPHA:268943)
- Pseudobulbar paralysis (HP:0007024): Bilateral impairment of the function of the cranial nerves 9-12, which control musculature involved in eating, swallowing, and speech. Pseudobulbar paralysis is characterized clinically by dysarthria, dysphonia, and dysphagia with bifacial paralysis, and may be accompanied by Pseudobulbar behavioral symptoms such as enforced crying and laughing. Evidence: TAS. Frequency: Frequent (HP:0040282). (ORPHA:268943)
- Generalized tonic seizure (HP:0010818): A generalized tonic seizure is a type of generalized motor seizure characterized by bilateral limb stiffening or elevation, often with neck stiffening without a subsequent clonic phase. The tonic activity can be a sustained abnormal posture, either in extension or flexion, sometimes accompanied by tremor of the extremities. Evidence: TAS. Frequency: Frequent (HP:0040282). (ORPHA:268943)
- Epistaxis (HP:0000421): Epistaxis, or nosebleed, refers to a hemorrhage localized in the nose. Evidence: TAS. Frequency: Occasional (HP:0040283). (ORPHA:268943)
- Visual impairment (HP:0000505): Visual impairment (or vision impairment) is vision loss (of a person) to such a degree as to qualify as an additional support need through a significant limitation of visual capability resulting from either disease, trauma, or congenital or degenerative conditions that cannot be corrected by conventional means, such as refractive correction, medication, or surgery. Evidence: TAS. Frequency: Occasional (HP:0040283). (ORPHA:268943)
- Esotropia (HP:0000565): A form of strabismus with one or both eyes turned inward ('crossed') to a relatively severe degree, usually defined as 10 diopters or more. Evidence: TAS. Frequency: Occasional (HP:0040283). (ORPHA:268943)
- Delayed speech and language development (HP:0000750): A degree of language development that is significantly below the norm for a child of a specified age. Evidence: TAS. Frequency: Occasional (HP:0040283). (ORPHA:268943)
- Cyanosis (HP:0000961): Bluish discoloration of the skin and mucosa due to poor circulation or inadequate oxygenation of arterial or capillary blood. Evidence: TAS. Frequency: Occasional (HP:0040283). (ORPHA:268943)
- Mild intellectual disability (HP:0001256): Mild intellectual disability (ID) is defined as a type of ID characterized by mildly sub-average adaptive functioning and intellectual functioning, with an intelligence quotient (IQ) the range of 50-69. Evidence: TAS. Frequency: Occasional (HP:0040283). (ORPHA:268943)
- Motor delay (HP:0001270): A type of Developmental delay characterized by a delay in acquiring motor skills. Evidence: TAS. Frequency: Occasional (HP:0040283). (ORPHA:268943)
- Stroke (HP:0001297): Sudden impairment of blood flow to a part of the brain due to occlusion or rupture of an artery to the brain. Evidence: TAS. Frequency: Occasional (HP:0040283). (ORPHA:268943)
- Giant somatosensory evoked potentials (HP:0001312): An abnormal enlargement (i.e. increase in measured voltage) of somatosensory evoked potentials. Evidence: TAS. Frequency: Occasional (HP:0040283). (ORPHA:268943)
- Myoclonus (HP:0001336): Very brief, involuntary random muscular contractions occurring at rest, in response to sensory stimuli, or accompanying voluntary movements. Evidence: TAS. Frequency: Occasional (HP:0040283). (ORPHA:268943)
- Abnormal facial shape (HP:0001999): An abnormal morphology (form) of the face or its components. Evidence: TAS. Frequency: Occasional (HP:0040283). (ORPHA:268943)
- Apnea (HP:0002104): Lack of breathing with no movement of the respiratory muscles and no exchange of air in the lungs. This term refers to a disposition to have recurrent episodes of apnea rather than to a single event. Evidence: TAS. Frequency: Occasional (HP:0040283). (ORPHA:268943)
- Status epilepticus (HP:0002133): Status epilepticus is a type of prolonged seizure resulting either from the failure of the mechanisms responsible for seizure termination or from the initiation of mechanisms which lead to abnormally prolonged seizures (after time point t1). It is a condition that can have long-term consequences (after time point t2), including neuronal death, neuronal injury, and alteration of neuronal networks, depending on the type and duration of seizures. Evidence: TAS. Frequency: Occasional (HP:0040283). (ORPHA:268943)
- Focal impaired awareness seizure (HP:0002384): Focal impaired awareness seizure (or focal seizure with impaired or lost awareness) is a type of focal-onset seizure characterized by some degree (which may be partial) of impairment of the person's awareness of themselves or their surroundings at any point during the seizure. Evidence: TAS. Frequency: Occasional (HP:0040283). (ORPHA:268943)
- Poor head control (HP:0002421): Difficulty to maintain correct position of the head while standing or sitting. Infant head lag is observed when the head seems to flop around or lags posteriorly behind the trunk. Several articles have maintained that head lag should be absent by age 3 to 4 months. Evidence: TAS. Frequency: Occasional (HP:0040283). (ORPHA:268943)
- Abnormal posturing (HP:0002533): Involuntary flexion or extension of the arms and legs. Evidence: TAS. Frequency: Occasional (HP:0040283). (ORPHA:268943)
- Involuntary movements (HP:0004305): Involuntary contractions of muscle leading to involuntary movements of extremities, neck, trunk, or face. Evidence: TAS. Frequency: Occasional (HP:0040283). (ORPHA:268943)
- Pulmonary arteriovenous malformation (HP:0006548): Pulmonary arteriovenous malformation, a condition most commonly associated with hereditary hemorrhagic telangiectasia, is an abnormal communication between the pulmonary artery and pulmonary vein without an intervening capillary communication. HRCT images usually show a coarse spidery appearance of the peripheral vascular markings in the lungs. More specific findings are obtained in the pulmonary angiogram where the normally invisible capillary phase is replaced by irregular vascular channels bridging the peripheral branches of pulmonary arteries and veins. Evidence: TAS. Frequency: Occasional (HP:0040283). (ORPHA:268943)
- Focal-onset seizure (HP:0007359): A focal-onset seizure is a type of seizure originating within networks limited to one hemisphere. They may be discretely localized or more widely distributed, and may originate in subcortical structures. Evidence: TAS. Frequency: Occasional (HP:0040283). (ORPHA:268943)
- Infantile sensorineural hearing impairment (HP:0008610): A form of sensorineural hearing impairment with infantile onset. Evidence: TAS. Frequency: Occasional (HP:0040283). (ORPHA:268943)
- Axial hypotonia (HP:0008936): Muscular hypotonia (abnormally low muscle tone) affecting the musculature of the trunk. Evidence: TAS. Frequency: Occasional (HP:0040283). (ORPHA:268943)
- Severe global developmental delay (HP:0011344): A severe delay in the achievement of motor or mental milestones in the domains of development of a child. Evidence: TAS. Frequency: Occasional (HP:0040283). (ORPHA:268943)
- Appendicular hypotonia (HP:0012389): Muscular hypotonia of one or more limbs. Evidence: TAS. Frequency: Occasional (HP:0040283). (ORPHA:268943)
- Infantile spasms (HP:0012469): Infantile spasms represent a subset of "epileptic spasms". Infantile Spasms are epileptic spasms starting in the first year of life (infancy). Evidence: TAS. Frequency: Occasional (HP:0040283). (ORPHA:268943)
- Perisylvian polymicrogyria (HP:0012650): Polymicrogyria (an excessive number of small gyri or convolutions) that is maximal in perisylvian regions (the regions that surround the Sylvian fissures), which may be symmetric or asymmetric and may extend beyond perisylvian regions. The Sylvian fissures often extend posteriorly and superiorly. Evidence: TAS. Frequency: Occasional (HP:0040283). (ORPHA:268943)
- Microcephaly (HP:0000252): Head circumference below 2 standard deviations below the mean for age and gender. Evidence: TAS. Frequency: Very rare (HP:0040284). (ORPHA:268943)
- Bimanual synkinesia (HP:0001335): Involuntary movements of one hand that accompany and mirror intentional movements of the opposite hand. Evidence: TAS. Frequency: Very rare (HP:0040284). (ORPHA:268943)
- Abnormal heart morphology (HP:0001627): Any structural anomaly of the heart. Evidence: TAS. Frequency: Very rare (HP:0040284). (ORPHA:268943)
- Nasogastric tube feeding (HP:0040288): The condition of inability to eat normally treated by placement of a thin tube through the nose into the stomach that is then used to carry food. Evidence: TAS. Frequency: Very rare (HP:0040284). (ORPHA:268943)